- X-linked inheritance (HP:0001417): A mode of inheritance that is observed for traits related to a gene encoded on the X chromosome. Evidence: IEA. (OMIM:309100)
- Macular dystrophy (HP:0007754): Macular dystrophy is a nonspecific term for retinal degeneration, generally confined to the macula, usually presumed of genetic origin. Evidence: IEA. (OMIM:309100)
These phenotypes are associated with the disease macular dystrophy, X-linked (OMIM:309100).